- Microcephaly (HP:0000252): Head circumference below 2 standard deviations below the mean for age and gender. Evidence: TAS. Frequency: Very frequent (HP:0040281). (ORPHA:2850)
- Hearing impairment (HP:0000365): A decreased magnitude of the sensory perception of sound. Evidence: TAS. Frequency: Very frequent (HP:0040281). (ORPHA:2850)
- Intellectual disability (HP:0001249): The term intellectual disability or intellectual developmental disorder is used to describe significantly sub-average intellectual and adaptive functioning based on clinical assessment and as measured by individually administered, appropriately normed, standardized and validated tests of intellectual functioning and adaptive behavior, with onset during the developmental period from infancy through adolescence. Evidence: TAS. Frequency: Very frequent (HP:0040281). (ORPHA:2850)
- Hypotonia (HP:0001252): Hypotonia is an abnormally low muscle tone (the amount of tension or resistance to movement in a muscle). Even when relaxed, muscles have a continuous and passive partial contraction which provides some resistance to passive stretching. Hypotonia thus manifests as diminished resistance to passive stretching. Hypotonia is not the same as muscle weakness, although the two conditions can co-exist. Evidence: TAS. Frequency: Very frequent (HP:0040281). (ORPHA:2850)
- Alopecia (HP:0001596): A noncongenital process of hair loss, which may progress to partial or complete baldness. Evidence: TAS. Frequency: Very frequent (HP:0040281). (ORPHA:2850)
- Sparse scalp hair (HP:0002209): Decreased number of hairs per unit area of skin of the scalp. Evidence: TAS. Frequency: Very frequent (HP:0040281). (ORPHA:2850)
- Sparse body hair (HP:0002231): Sparseness of the body hair. Evidence: TAS. Frequency: Very frequent (HP:0040281). (ORPHA:2850)
- Delayed skeletal maturation (HP:0002750): A decreased rate of skeletal maturation. Delayed skeletal maturation can be diagnosed on the basis of an estimation of the bone age from radiographs of specific bones in the human body. Evidence: TAS. Frequency: Very frequent (HP:0040281). (ORPHA:2850)
- Aplasia/Hypoplasia of the eyebrow (HP:0100840): Absence or underdevelopment of the eyebrow. Evidence: TAS. Frequency: Very frequent (HP:0040281). (ORPHA:2850)
- Photophobia (HP:0000613): Excessive sensitivity to light with the sensation of discomfort or pain in the eyes due to exposure to bright light. Evidence: TAS. Frequency: Frequent (HP:0040282). (ORPHA:2850)
- Hypergonadotropic hypogonadism (HP:0000815): Reduced function of the gonads (testes in males or ovaries in females) associated with excess pituitary gonadotropin secretion and resulting in delayed sexual development and growth delay. Evidence: TAS. Frequency: Frequent (HP:0040282). (ORPHA:2850)
- Brachydactyly (HP:0001156): Digits that appear disproportionately short compared to the hand/foot. The word brachydactyly is used here to describe a series distinct patterns of shortened digits (brachydactyly types A-E). This is the sense used here. Evidence: TAS. Frequency: Frequent (HP:0040282). (ORPHA:2850)
- Split hand (HP:0001171): A condition in which middle parts of the hand (fingers and metacarpals) are missing giving a cleft appearance. The severity is very variable ranging from slightly hypoplastic middle fingers over absent middle fingers as far as oligo- or monodactyl hands. Evidence: TAS. Frequency: Frequent (HP:0040282). (ORPHA:2850)
- Seizure (HP:0001250): A seizure is an intermittent abnormality of nervous system physiology characterized by a transient occurrence of signs and/or symptoms due to abnormal excessive or synchronous neuronal activity in the brain. Evidence: TAS. Frequency: Frequent (HP:0040282). (ORPHA:2850)
- Growth delay (HP:0001510): A deficiency or slowing down of growth pre- and postnatally. Evidence: TAS. Frequency: Frequent (HP:0040282). (ORPHA:2850)
- EEG abnormality (HP:0002353): Abnormality observed by electroencephalogram (EEG), which is used to record of the brain's spontaneous electrical activity from multiple electrodes placed on the scalp. Evidence: TAS. Frequency: Frequent (HP:0040282). (ORPHA:2850)
- Short stature (HP:0004322): A height below that which is expected according to age and gender norms. Although there is no universally accepted definition of short stature, many refer to "short stature" as height more than 2 standard deviations below the mean for age and gender (or below the 3rd percentile for age and gender dependent norms). Evidence: TAS. Frequency: Frequent (HP:0040282). (ORPHA:2850)
- Ichthyosis (HP:0008064): An abnormality of the skin characterized the presence of excessive amounts of dry surface scales on the skin resulting from an abnormality of keratinization. Evidence: TAS. Frequency: Frequent (HP:0040282). (ORPHA:2850)
- Sparse hair (HP:0008070): Reduced density of hairs. Evidence: TAS. Frequency: Frequent (HP:0040282). (ORPHA:2850)
- Abnormal skeletal morphology (HP:0011842): An abnormality of the form, structure, or size of the skeletal system. Evidence: TAS. Frequency: Frequent (HP:0040282). (ORPHA:2850)
- Short corpus callosum (HP:0200012). Evidence: TAS. Frequency: Frequent (HP:0040282). (ORPHA:2850)
- Macrotia (HP:0000400): Median longitudinal ear length greater than two standard deviations above the mean and median ear width greater than two standard deviations above the mean (objective); or, apparent increase in length and width of the pinna (subjective). Evidence: TAS. Frequency: Occasional (HP:0040283). (ORPHA:2850)
- Hyperkeratosis (HP:0000962): Hyperkeratosis is a histopathological term defining a thickened stratum corneum and may be present in many different skin conditions, with many possible overlaps. Hyperkeratosis refers to the increased thickness of the stratum corneum, the outer layer of the skin. Hyperkeratosis is subclassified as orthokeratotic or parakeratotic. Orthokeratotic hyperkeratosis refers to the thickening of the keratin layer with preserved keratinocyte maturation, while parakeratotic hyperkeratosis shows retained nuclei as a sign of delayed maturation of keratinocytes. Evidence: TAS. Frequency: Occasional (HP:0040283). (ORPHA:2850)
- Flexion contracture (HP:0001371): A flexion contracture is a bent (flexed) joint that cannot be straightened actively or passively. It is thus a chronic loss of joint motion due to structural changes in muscle, tendons, ligaments, or skin that prevents normal movement of joints. Evidence: TAS. Frequency: Occasional (HP:0040283). (ORPHA:2850)
- Scoliosis (HP:0002650): The presence of an abnormal lateral curvature of the spine. Evidence: TAS. Frequency: Occasional (HP:0040283). (ORPHA:2850)
- Abnormal nasal morphology (HP:0005105). Evidence: TAS. Frequency: Occasional (HP:0040283). (ORPHA:2850)
These phenotypes are associated with the disease Alopecia-intellectual disability syndrome (ORPHA:2850).